- Nystagmus (HP:0000639): Rhythmic, involuntary oscillations of one or both eyes related to abnormality in fixation, conjugate gaze, or vestibular mechanisms. Evidence: PCS. (PMID:16384941)
- Reduced visual acuity (HP:0007663). Evidence: IEA. (OMIM:613837)
- Visual impairment (HP:0000505): Visual impairment (or vision impairment) is vision loss (of a person) to such a degree as to qualify as an additional support need through a significant limitation of visual capability resulting from either disease, trauma, or congenital or degenerative conditions that cannot be corrected by conventional means, such as refractive correction, medication, or surgery. Evidence: PCS. (PMID:16384941)
- Autosomal dominant inheritance (HP:0000006): A mode of inheritance that is observed for traits related to a gene encoded on one of the autosomes (i.e., the human chromosomes 1-22) in which a trait manifests in heterozygotes. In the context of medical genetics, an autosomal dominant disorder is caused when a single copy of the mutant allele is present. Males and females are affected equally, and can both transmit the disorder with a risk of 50% for each child of inheriting the mutant allele. Evidence: PCS. (PMID:16384941)
These phenotypes are associated with the disease Leber congenital amaurosis 11 (OMIM:613837).